- Large hands (HP:0001176). Evidence: PCS. (OMIM:102100)
- Tall stature (HP:0000098): A height above that which is expected according to age and gender norms. Evidence: PCS. (OMIM:102100)
- Periostosis (HP:0030314): Abnormal deposition of periosteal bone. Evidence: TAS. (OMIM:102100)
- Long foot (HP:0001833): Increased back to front length of the foot. Evidence: TAS. (OMIM:102100)
- Soft skin (HP:0000977): Subjective impression of increased softness upon palpation of the skin. Evidence: IEA. (OMIM:102100)
- Cutis gyrata of scalp (HP:0010541): The presence of convoluted folds and furrows formed from thickened skin of the scalp, resembling cerebriform pattern. The scalp has convoluted and elevated folds, 1 to 2 cm in thickness. The convolutions generally cannot be flattened by traction. Evidence: PCS. (OMIM:102100)
- Autosomal dominant inheritance (HP:0000006): A mode of inheritance that is observed for traits related to a gene encoded on one of the autosomes (i.e., the human chromosomes 1-22) in which a trait manifests in heterozygotes. In the context of medical genetics, an autosomal dominant disorder is caused when a single copy of the mutant allele is present. Males and females are affected equally, and can both transmit the disorder with a risk of 50% for each child of inheriting the mutant allele. Evidence: IEA. (OMIM:102100)
- Mandibular prognathia (HP:0000303): Abnormal prominence of the chin related to increased length of the mandible. Evidence: PCS. (OMIM:102100)
- Abnormality of the eye (HP:0000478): Any abnormality of the eye, including location, spacing, and intraocular abnormalities. Evidence: IEA. (OMIM:102100)
These phenotypes are associated with the disease acromegaloid changes, cutis verticis gyrata, and corneal leukoma (OMIM:102100).